- Large fontanelles (HP:0000239): In newborns, the two frontal bones, two parietal bones, and one occipital bone are joined by fibrous sutures, which form a small posterior fontanelle, and a larger, diamond-shaped anterior fontanelle. These regions allow for the skull to pass the birth canal and for later growth. The fontanelles gradually ossify, whereby the posterior fontanelle usually closes by eight weeks and the anterior fontanelle by the 9th to 16th month of age. Large fontanelles are diagnosed if the fontanelles are larger than age-dependent norms. Evidence: TAS. Frequency: Very frequent (HP:0040281). (ORPHA:2249)
- Delayed cranial suture closure (HP:0000270): Infants normally have two fontanels at birth, the diamond-shaped anterior fontanelle at the junction of the coronal and sagittal sutures, and the posterior fontanelle at the intersection of the occipital and parietal bones. The posterior fontanelle usually closes by the 8th week of life, and the anterior fontanel closes by the 18th month of life on average. This term applies if there is delay of closure of the fontanelles beyond the normal age. Evidence: TAS. Frequency: Very frequent (HP:0040281). (ORPHA:2249)
- Intellectual disability (HP:0001249): The term intellectual disability or intellectual developmental disorder is used to describe significantly sub-average intellectual and adaptive functioning based on clinical assessment and as measured by individually administered, appropriately normed, standardized and validated tests of intellectual functioning and adaptive behavior, with onset during the developmental period from infancy through adolescence. Evidence: TAS. Frequency: Very frequent (HP:0040281). (ORPHA:2249)
- Hypotonia (HP:0001252): Hypotonia is an abnormally low muscle tone (the amount of tension or resistance to movement in a muscle). Even when relaxed, muscles have a continuous and passive partial contraction which provides some resistance to passive stretching. Hypotonia thus manifests as diminished resistance to passive stretching. Hypotonia is not the same as muscle weakness, although the two conditions can co-exist. Evidence: TAS. Frequency: Very frequent (HP:0040281). (ORPHA:2249)
- Global developmental delay (HP:0001263): A delay in the achievement of motor or mental milestones in the domains of development of a child, including motor skills, speech and language, cognitive skills, and social and emotional skills. This term should only be used to describe children younger than five years of age. Evidence: TAS. Frequency: Very frequent (HP:0040281). (ORPHA:2249)
- Specific learning disability (HP:0001328): Impairment of certain skills such as reading or writing, coordination, self-control, or attention that interfere with the ability to learn. The impairment is not related to a global deficiency of intelligence. Evidence: TAS. Frequency: Very frequent (HP:0040281). (ORPHA:2249)
- Joint stiffness (HP:0001387): Joint stiffness is a perceived sensation of tightness in a joint or joints when attempting to move them after a period of inactivity. Joint stiffness typically subsides over time. Evidence: TAS. Frequency: Very frequent (HP:0040281). (ORPHA:2249)
- Absent toenail (HP:0001802): Congenital absence of the toenail. Evidence: TAS. Frequency: Very frequent (HP:0040281). (ORPHA:2249)
- Absent fingernail (HP:0001817): Absence of a fingernail. Evidence: TAS. Frequency: Very frequent (HP:0040281). (ORPHA:2249)
- Metatarsus adductus (HP:0001840): The metatarsals are deviated medially (tibially), that is, the bones in the front half of the foot bend or turn in toward the body. Evidence: TAS. Frequency: Very frequent (HP:0040281). (ORPHA:2249)
- Talipes (HP:0001883): A deformity of foot and ankle that has different subtypes that are talipes equinovarus, talipes equinovalgus, talipes calcaneovarus and talipes calcaneovalgus. Evidence: TAS. Frequency: Very frequent (HP:0040281). (ORPHA:2249)
- Micromelia (HP:0002983): The presence of abnormally small extremities. Evidence: TAS. Frequency: Very frequent (HP:0040281). (ORPHA:2249)
- Hypoplasia of the radius (HP:0002984): Underdevelopment of the radius. Evidence: TAS. Frequency: Very frequent (HP:0040281). (ORPHA:2249)
- Hypoplasia of the ulna (HP:0003022): Underdevelopment of the ulna. Evidence: TAS. Frequency: Very frequent (HP:0040281). (ORPHA:2249)
- Mesomelia (HP:0003027): Shortening of the middle parts of the limbs (forearm and lower leg) in relation to the upper and terminal segments. Evidence: TAS. Frequency: Very frequent (HP:0040281). (ORPHA:2249)
- Elbow dislocation (HP:0003042): Dislocation of the distal humerus out of the elbow joint, where the radius, ulna, and humerus meet. Evidence: TAS. Frequency: Very frequent (HP:0040281). (ORPHA:2249)
- Severe short stature (HP:0003510): A severe degree of short stature, more than -4 SD from the mean corrected for age and sex. Evidence: TAS. Frequency: Very frequent (HP:0040281). (ORPHA:2249)
- Ulnar deviation of finger (HP:0009465): Bending or curvature of a finger toward the ulnar side (i.e., away from the thumb). The deviation is at the metacarpal-phalangeal joint, and this finding is distinct from clinodactyly. Evidence: TAS. Frequency: Very frequent (HP:0040281). (ORPHA:2249)
- Broad hallux phalanx (HP:0010059): An increase in width in one or more phalanges of the big toe. Evidence: TAS. Frequency: Frequent (HP:0040282). (ORPHA:2249)
- Broad thumb (HP:0011304): Increased thumb width without increased dorso-ventral dimension. Evidence: TAS. Frequency: Frequent (HP:0040282). (ORPHA:2249)
These phenotypes are associated with the disease Ulna hypoplasia-intellectual disability syndrome (ORPHA:2249).